Phenotypes associated with the disease Craniofacial-deafness-hand syndrome (ORPHA:1529):
- Narrow mouth (HP:0000160): Distance between the commissures of the mouth more than 2 SD below the mean. Alternatively, an apparently decreased width of the oral aperture (subjective). Evidence: TAS. Frequency: Very frequent (HP:0040281). (ORPHA:1529)
- Narrow face (HP:0000275): Bizygomatic (upper face) and bigonial (lower face) width are both more than 2 standard deviations below the mean (objective); or, an apparent reduction in the width of the upper and lower face (subjective). Evidence: TAS. Frequency: Very frequent (HP:0040281). (ORPHA:1529)
- Hypertelorism (HP:0000316): Interpupillary distance more than 2 SD above the mean (alternatively, the appearance of an increased interpupillary distance or widely spaced eyes). Evidence: TAS. Frequency: Very frequent (HP:0040281). (ORPHA:1529)
- Hypoplasia of the maxilla (HP:0000327): Abnormally small dimension of the Maxilla. Usually creating a malocclusion or malalignment between the upper and lower teeth or resulting in a deficient amount of projection of the base of the nose and lower midface region. Evidence: TAS. Frequency: Very frequent (HP:0040281). (ORPHA:1529)
- Sensorineural hearing impairment (HP:0000407): A type of hearing impairment in one or both ears related to an abnormal functionality of the cochlear nerve. Evidence: TAS. Frequency: Very frequent (HP:0040281). (ORPHA:1529)
- Depressed nasal ridge (HP:0000457): Lack of prominence of the nose resulting from a posteriorly-placed nasal ridge. Evidence: TAS. Frequency: Very frequent (HP:0040281). (ORPHA:1529)
- Downslanted palpebral fissures (HP:0000494): The palpebral fissure inclination is more than two standard deviations below the mean. Evidence: TAS. Frequency: Very frequent (HP:0040281). (ORPHA:1529)
- Lacrimal duct atresia (HP:0000564): A developmental disorder of the lacrimal drainage system that most often affects the lacrimal ostium and resulting in non-opening of the nasolacrimal duct. It usually results from a non-canalization of the nasolacrimal duct. Evidence: TAS. Frequency: Very frequent (HP:0040281). (ORPHA:1529)
- Blepharophimosis (HP:0000581): A fixed reduction in the vertical distance between the upper and lower eyelids with short palpebral fissures. Evidence: TAS. Frequency: Very frequent (HP:0040281). (ORPHA:1529)
- Abnormality of the wrist (HP:0003019): Abnormality of the wrist, the structure connecting the hand and the forearm. Evidence: TAS. Frequency: Very frequent (HP:0040281). (ORPHA:1529)
- Ulnar deviation of the wrist (HP:0003049). Evidence: TAS. Frequency: Very frequent (HP:0040281). (ORPHA:1529)
- Short nose (HP:0003196): Distance from nasion to subnasale more than two standard deviations below the mean, or alternatively, an apparently decreased length from the nasal root to the nasal tip. Evidence: TAS. Frequency: Very frequent (HP:0040281). (ORPHA:1529)
- Depressed nasal bridge (HP:0005280): Posterior positioning of the nasal root in relation to the overall facial profile for age. Evidence: TAS. Frequency: Very frequent (HP:0040281). (ORPHA:1529)
- Ulnar deviation of finger (HP:0009465): Bending or curvature of a finger toward the ulnar side (i.e., away from the thumb). The deviation is at the metacarpal-phalangeal joint, and this finding is distinct from clinodactyly. Evidence: TAS. Frequency: Very frequent (HP:0040281). (ORPHA:1529)
- Aplasia/Hypoplasia involving the nose (HP:0009924): Underdevelopment or absence of the nose or parts thereof. Evidence: TAS. Frequency: Very frequent (HP:0040281). (ORPHA:1529)
- Flat face (HP:0012368): Absence of concavity or convexity of the face when viewed in profile. Evidence: TAS. Frequency: Very frequent (HP:0040281). (ORPHA:1529)
- Camptodactyly of finger (HP:0100490): The distal interphalangeal joint and/or the proximal interphalangeal joint of the fingers cannot be extended to 180 degrees by either active or passive extension. Evidence: TAS. Frequency: Frequent (HP:0040282). (ORPHA:1529)